- Hypertension (HP:0000822): The presence of chronic increased pressure in the systemic arterial system. Evidence: TAS. Frequency: Obligate (HP:0040280). (ORPHA:231632)
- Decreased circulating renin concentration (HP:0003351): An decreased level of renin in the blood. Evidence: TAS. Frequency: Obligate (HP:0040280). (ORPHA:231632)
- Glucocortocoid-insensitive primary hyperaldosteronism (HP:0011740): A form of primary hyperaldosteronism in which the overproduction of aldosterone cannot be suppressed by the administration of dexamethasone or similar glucocorticoids. Evidence: TAS. Frequency: Obligate (HP:0040280). (ORPHA:231632)
- Headache (HP:0002315): Cephalgia, or pain sensed in various parts of the head, not confined to the area of distribution of any nerve. Evidence: TAS. Frequency: Very frequent (HP:0040281). (ORPHA:231632)
- Hypokalemia (HP:0002900): The concentration of potassium(1+) in the blood circulation is below the lower limit of normal. Evidence: TAS. Frequency: Very frequent (HP:0040281). (ORPHA:231632)
- Renal cortical adenoma (HP:0006735): The presence of an adenoma in the cortex of the kidney. Evidence: TAS. Frequency: Very frequent (HP:0040281). (ORPHA:231632)
- Ovarian neoplasm (HP:0100615): A tumor (abnormal growth of tissue) of the ovary. Evidence: TAS. Frequency: Very frequent (HP:0040281). (ORPHA:231632)
- Metabolic alkalosis (HP:0200114): Metabolic alkalosis is defined as a disease state where the pH is elevated to greater than 7.45 secondary to some metabolic process. Evidence: TAS. Frequency: Frequent (HP:0040282). (ORPHA:231632)
- Tinnitus (HP:0000360): Tinnitus is an auditory perception that can be described as the experience of sound, in the ear or in the head, in the absence of external acoustic stimulation. Evidence: TAS. Frequency: Occasional (HP:0040283). (ORPHA:231632)
- Epistaxis (HP:0000421): Epistaxis, or nosebleed, refers to a hemorrhage localized in the nose. Evidence: TAS. Frequency: Occasional (HP:0040283). (ORPHA:231632)
- Muscle weakness (HP:0001324): Reduced strength of muscles. Evidence: TAS. Frequency: Occasional (HP:0040283). (ORPHA:231632)
- Nausea (HP:0002018): A sensation of unease in the stomach together with an urge to vomit. Evidence: TAS. Frequency: Occasional (HP:0040283). (ORPHA:231632)
These phenotypes are associated with the disease Ectopic aldosterone-producing tumor (ORPHA:231632).
The following phenotypes are NOT associated with this disease:
- Adrenocortical adenoma (HP:0008256): Adrenocortical adenomas are benign tumors of the adrenal cortex. Evidence: TAS. (ORPHA:231632)